Phenotypes associated with the disease developmental and epileptic encephalopathy, 52 (OMIM:617350):
- Bilateral tonic-clonic seizure (HP:0002069): A bilateral tonic-clonic seizure is a seizure defined by a tonic (bilateral increased tone, lasting seconds to minutes) and then a clonic (bilateral sustained rhythmic jerking) phase. Evidence: PCS. Frequency: 1/1. (PMID:19710327)
- Focal hemiclonic seizure (HP:0006813): A type of focal clonic seizure characterized by sustained rhythmic jerking rapidly involves one side of the body at seizure onset. Evidence: TAS. (OMIM:617350)
- Generalized myoclonic seizure (HP:0002123): A generalized myoclonic seizure is a type of generalized motor seizure characterized by bilateral, sudden, brief (<100 ms) involuntary single or multiple contraction of muscles or muscle groups of variable topography (axial, proximal limb, distal). Myoclonus is less regularly repetitive and less sustained than is clonus. Evidence: PCS. Frequency: 1/1. (PMID:19710327)
- Febrile seizure (within the age range of 3 months to 6 years) (HP:0002373): A febrile seizure is any type of seizure (most often a generalized tonic-clonic seizure) occurring with fever (at least 38 degrees Celsius) but in the absence of central nervous system infection, severe metabolic disturbance or other alternative precipitant in children between the ages of 3 months and 6 years. Evidence: TAS. (OMIM:617350)
- Seizure (HP:0001250): A seizure is an intermittent abnormality of nervous system physiology characterized by a transient occurrence of signs and/or symptoms due to abnormal excessive or synchronous neuronal activity in the brain. Evidence: TAS. (OMIM:617350)
- Global developmental delay (HP:0001263): A delay in the achievement of motor or mental milestones in the domains of development of a child, including motor skills, speech and language, cognitive skills, and social and emotional skills. This term should only be used to describe children younger than five years of age. Evidence: TAS. (OMIM:617350)
- Infantile onset (HP:0003593): Onset of signs or symptoms of disease between 28 days to one year of life. Evidence: PCS. Frequency: 1/1. (PMID:19710327)
- Generalized hypotonia (HP:0001290): Generalized muscular hypotonia (abnormally low muscle tone). Evidence: PCS. Frequency: 1/1. (PMID:19710327)
- Limb ataxia (HP:0002070): A kind of ataxia that affects movements of the extremities. Evidence: TAS. (OMIM:617350)
- Atypical absence seizure (HP:0007270): An atypical absence seizure is a type of generalized non-motor (absence) seizure characterized by interruption of ongoing activities and reduced responsiveness. In comparison to a typical absence seizure, changes in tone may be more pronounced, onset and/or cessation may be less abrupt, and the duration of the ictus and post-ictal recovery may be longer. Although not always available, an EEG often demonstrates slow (<3 Hz), irregular, generalized spike-wave activity. Evidence: TAS. (OMIM:617350)
- Developmental stagnation (HP:0007281): A cessation of the development of a child in the areas of motor skills, speech and language, cognitive skills, and social and/or emotional skills. Evidence: IEA. (OMIM:617350)
- Death in childhood (HP:0003819): Death in during childhood, defined here as between the ages of 2 and 10 years. Evidence: PCS. Frequency: 1/1. (PMID:19710327)
- Autosomal recessive inheritance (HP:0000007): A mode of inheritance that is observed for traits related to a gene encoded on one of the autosomes (i.e., the human chromosomes 1-22) in which a trait manifests in individuals with two pathogenic alleles, either homozygotes (two copies of the same mutant allele) or compound heterozygotes (whereby each copy of a gene has a distinct mutant allele). Evidence: PCS. (PMID:19710327)
- Abnormal pyramidal sign (HP:0007256): Functional neurological abnormalities related to dysfunction of the pyramidal tract. Evidence: TAS. (OMIM:617350)
- Epileptic encephalopathy (HP:0200134): A condition in which epileptiform abnormalities are believed to contribute to the progressive disturbance in cerebral function. Epileptic encephalaopathy is characterized by (1) electrographic EEG paroxysmal activity that is often aggressive, (2) seizures that are usually multiform and intractable, (3) cognitive, behavioral and neurological deficits that may be relentless, and (4) sometimes early death. Evidence: TAS. (OMIM:617350)
- Spasticity (HP:0001257): A motor disorder characterized by a velocity-dependent increase in tonic stretch reflexes with increased muscle tone, exaggerated (hyperexcitable) tendon reflexes. Evidence: TAS. (OMIM:617350)